Phenotypes associated with the disease HAIRY EARS (OMIM:139500):
- Long hairs growing from helix of pinna (HP:0008528). Evidence: PCS. Frequency: 83/500. Onset: Adult onset (HP:0003581). (PMID:2364572)
- Long hairs growing from helix of pinna (HP:0008528). Evidence: PCS. Frequency: 2/500. Onset: Adult onset (HP:0003581). (PMID:2364572)
- Y-linked inheritance (HP:0001450): A mode of inheritance that is observed for traits related to a gene encoded on the Y chromosome. Evidence: TAS. (OMIM:139500)
- Autosomal dominant inheritance (HP:0000006): A mode of inheritance that is observed for traits related to a gene encoded on one of the autosomes (i.e., the human chromosomes 1-22) in which a trait manifests in heterozygotes. In the context of medical genetics, an autosomal dominant disorder is caused when a single copy of the mutant allele is present. Males and females are affected equally, and can both transmit the disorder with a risk of 50% for each child of inheriting the mutant allele. Evidence: TAS. (OMIM:139500)